- Downslanted palpebral fissures (HP:0000494): The palpebral fissure inclination is more than two standard deviations below the mean. Evidence: PCS. (PMID:14556253)
- Sensorineural hearing impairment (HP:0000407): A type of hearing impairment in one or both ears related to an abnormal functionality of the cochlear nerve. Evidence: PCS. (PMID:14556253)
- Telecanthus (HP:0000506): Distance between the inner canthi more than two standard deviations above the mean (objective); or, apparently increased distance between the inner canthi. Evidence: PCS. (PMID:14556253)
- Short nose (HP:0003196): Distance from nasion to subnasale more than two standard deviations below the mean, or alternatively, an apparently decreased length from the nasal root to the nasal tip. Evidence: PCS. (PMID:14556253)
- Ulnar deviation of the hand (HP:0009487): Divergence of the longitudinal axis of the hand at the wrist in a posterior (ulnar) direction (i.e., towards the little finger). Evidence: PCS. (PMID:14556253)
- Malar flattening (HP:0000272): Underdevelopment of the malar prominence of the jugal bone (zygomatic bone in mammals), appreciated in profile, frontal view, and/or by palpation. Evidence: PCS. (PMID:14556253)
- Hypertelorism (HP:0000316): Interpupillary distance more than 2 SD above the mean (alternatively, the appearance of an increased interpupillary distance or widely spaced eyes). Evidence: PCS. (PMID:14556253)
- Hypoplasia of the maxilla (HP:0000327): Abnormally small dimension of the Maxilla. Usually creating a malocclusion or malalignment between the upper and lower teeth or resulting in a deficient amount of projection of the base of the nose and lower midface region. Evidence: PCS. (PMID:14556253)
- Narrow naris (HP:0009933): Slender, slit-like aperture of the nostril. Evidence: PCS. (PMID:14556253)
- Flat face (HP:0012368): Absence of concavity or convexity of the face when viewed in profile. Evidence: PCS. (PMID:14556253)
- Depressed nasal bridge (HP:0005280): Posterior positioning of the nasal root in relation to the overall facial profile for age. Evidence: PCS. (PMID:14556253)
- Autosomal dominant inheritance (HP:0000006): A mode of inheritance that is observed for traits related to a gene encoded on one of the autosomes (i.e., the human chromosomes 1-22) in which a trait manifests in heterozygotes. In the context of medical genetics, an autosomal dominant disorder is caused when a single copy of the mutant allele is present. Males and females are affected equally, and can both transmit the disorder with a risk of 50% for each child of inheriting the mutant allele. Evidence: PCS. (PMID:8664898)
These phenotypes are associated with the disease craniofacial-deafness-hand syndrome (OMIM:122880).